- Decreased circulating complement C9 concentration (HP:0012308): Concentration of the complement component C9 in the blood circulation below the lower limit of normal. Evidence: TAS. (OMIM:613825)
This phenotype is associated with the disease complement component 9 deficiency (OMIM:613825).